Phenotypes associated with the disease Renpenning syndrome (ORPHA:3242):
- Microcephaly (HP:0000252): Head circumference below 2 standard deviations below the mean for age and gender. Evidence: TAS. Frequency: Very frequent (HP:0040281). (ORPHA:3242)
- Intellectual disability (HP:0001249): The term intellectual disability or intellectual developmental disorder is used to describe significantly sub-average intellectual and adaptive functioning based on clinical assessment and as measured by individually administered, appropriately normed, standardized and validated tests of intellectual functioning and adaptive behavior, with onset during the developmental period from infancy through adolescence. Evidence: TAS. Frequency: Very frequent (HP:0040281). (ORPHA:3242)
- Skeletal muscle atrophy (HP:0003202): The presence of skeletal muscular atrophy (which is also known as amyotrophy). Evidence: TAS. Frequency: Very frequent (HP:0040281). (ORPHA:3242)
- Severe short stature (HP:0003510): A severe degree of short stature, more than -4 SD from the mean corrected for age and sex. Evidence: TAS. Frequency: Very frequent (HP:0040281). (ORPHA:3242)
- Cachexia (HP:0004326): Severe weight loss, wasting of muscle, loss of appetite, and general debility related to a chronic disease. Evidence: TAS. Frequency: Very frequent (HP:0040281). (ORPHA:3242)
- Hypospadias (HP:0000047): Abnormal position of urethral meatus on the ventral penile shaft (underside) characterized by displacement of the urethral meatus from the tip of the glans penis to the ventral surface of the penis, scrotum, or perineum. Evidence: TAS. Frequency: Frequent (HP:0040282). (ORPHA:3242)
- Malar flattening (HP:0000272): Underdevelopment of the malar prominence of the jugal bone (zygomatic bone in mammals), appreciated in profile, frontal view, and/or by palpation. Evidence: TAS. Frequency: Frequent (HP:0040282). (ORPHA:3242)
- Small face (HP:0000274): A face that is short and narrow. Evidence: TAS. Frequency: Frequent (HP:0040282). (ORPHA:3242)
- Narrow face (HP:0000275): Bizygomatic (upper face) and bigonial (lower face) width are both more than 2 standard deviations below the mean (objective); or, an apparent reduction in the width of the upper and lower face (subjective). Evidence: TAS. Frequency: Frequent (HP:0040282). (ORPHA:3242)
- Long face (HP:0000276): Facial height (length) is more than 2 standard deviations above the mean (objective); or, an apparent increase in the height (length) of the face (subjective). Evidence: TAS. Frequency: Frequent (HP:0040282). (ORPHA:3242)
- Epicanthus (HP:0000286): A fold of skin starting above the medial aspect of the upper eyelid and arching downward to cover, pass in front of and lateral to the medial canthus. Evidence: TAS. Frequency: Frequent (HP:0040282). (ORPHA:3242)
- Mandibular prognathia (HP:0000303): Abnormal prominence of the chin related to increased length of the mandible. Evidence: TAS. Frequency: Frequent (HP:0040282). (ORPHA:3242)
- Short philtrum (HP:0000322): Distance between nasal base and midline upper lip vermilion border more than 2 SD below the mean. Alternatively, an apparently decreased distance between nasal base and midline upper lip vermilion border. Evidence: TAS. Frequency: Frequent (HP:0040282). (ORPHA:3242)
- Macrotia (HP:0000400): Median longitudinal ear length greater than two standard deviations above the mean and median ear width greater than two standard deviations above the mean (objective); or, apparent increase in length and width of the pinna (subjective). Evidence: TAS. Frequency: Frequent (HP:0040282). (ORPHA:3242)
- Prominent nose (HP:0000448): Distance between subnasale and pronasale more than two standard deviations above the mean, or alternatively, an apparently increased anterior protrusion of the nasal tip. Evidence: TAS. Frequency: Frequent (HP:0040282). (ORPHA:3242)
- Upslanted palpebral fissure (HP:0000582): The palpebral fissure inclination is more than two standard deviations above the mean for age (objective); or, the inclination of the palpebral fissure is greater than typical for age. Evidence: TAS. Frequency: Frequent (HP:0040282). (ORPHA:3242)
- Abnormal rib morphology (HP:0000772): An anomaly of the rib. Evidence: TAS. Frequency: Frequent (HP:0040282). (ORPHA:3242)
- Sprengel anomaly (HP:0000912): A congenital skeletal deformity characterized by the elevation of one scapula (thus, one scapula is located superior to the other). Evidence: TAS. Frequency: Frequent (HP:0040282). (ORPHA:3242)
- Growth delay (HP:0001510): A deficiency or slowing down of growth pre- and postnatally. Evidence: TAS. Frequency: Frequent (HP:0040282). (ORPHA:3242)
- Alopecia (HP:0001596): A noncongenital process of hair loss, which may progress to partial or complete baldness. Evidence: TAS. Frequency: Frequent (HP:0040282). (ORPHA:3242)
- Decreased testicular size (HP:0008734): Reduced volume of the testicle (the male gonad). Evidence: TAS. Frequency: Frequent (HP:0040282). (ORPHA:3242)
- Thin eyebrow (HP:0045074): Decreased diameter of eyebrow hairs. Evidence: TAS. Frequency: Frequent (HP:0040282). (ORPHA:3242)
- Round ear (HP:0100830). Evidence: TAS. Frequency: Frequent (HP:0040282). (ORPHA:3242)
- Narrow mouth (HP:0000160): Distance between the commissures of the mouth more than 2 SD below the mean. Alternatively, an apparently decreased width of the oral aperture (subjective). Evidence: TAS. Frequency: Occasional (HP:0040283). (ORPHA:3242)
- Cleft palate (HP:0000175): Cleft palate is a developmental defect of the palate resulting from a failure of fusion of the palatine processes and manifesting as a separation of the roof of the mouth (soft and hard palate). Evidence: TAS. Frequency: Occasional (HP:0040283). (ORPHA:3242)
- Sensorineural hearing impairment (HP:0000407): A type of hearing impairment in one or both ears related to an abnormal functionality of the cochlear nerve. Evidence: TAS. Frequency: Occasional (HP:0040283). (ORPHA:3242)
- Strabismus (HP:0000486): A misalignment of the eyes so that the visual axes deviate from bifoveal fixation. The classification of strabismus may be based on a number of features including the relative position of the eyes, whether the deviation is latent or manifest, intermittent or constant, concomitant or otherwise and according to the age of onset and the relevance of any associated refractive error. Evidence: TAS. Frequency: Occasional (HP:0040283). (ORPHA:3242)
- Cataract (HP:0000518): A cataract is an opacity or clouding that develops in the crystalline lens of the eye or in its capsule. Evidence: TAS. Frequency: Occasional (HP:0040283). (ORPHA:3242)
- Iris coloboma (HP:0000612): A coloboma of the iris. Evidence: TAS. Frequency: Occasional (HP:0040283). (ORPHA:3242)
- Pectus excavatum (HP:0000767): A defect of the chest wall characterized by a depression of the sternum, giving the chest ("pectus") a caved-in ("excavatum") appearance. Evidence: TAS. Frequency: Occasional (HP:0040283). (ORPHA:3242)
- Diabetes mellitus (HP:0000819): A group of abnormalities characterized by hyperglycemia and glucose intolerance. Evidence: TAS. Frequency: Occasional (HP:0040283). (ORPHA:3242)
- Abnormal thumb morphology (HP:0001172): An abnormal structure of the first digit of the hand. Evidence: TAS. Frequency: Occasional (HP:0040283). (ORPHA:3242)
- Seizure (HP:0001250): A seizure is an intermittent abnormality of nervous system physiology characterized by a transient occurrence of signs and/or symptoms due to abnormal excessive or synchronous neuronal activity in the brain. Evidence: TAS. Frequency: Occasional (HP:0040283). (ORPHA:3242)
- Joint stiffness (HP:0001387): Joint stiffness is a perceived sensation of tightness in a joint or joints when attempting to move them after a period of inactivity. Joint stiffness typically subsides over time. Evidence: TAS. Frequency: Occasional (HP:0040283). (ORPHA:3242)
- Macrodontia (HP:0001572): Increased size of the teeth, which can be defined as a mesiodistal tooth diameter (width) more than 2 SD above mean for age. Alternatively, an apparently increased maximum width of the tooth. Evidence: TAS. Frequency: Occasional (HP:0040283). (ORPHA:3242)
- Anal atresia (HP:0002023): Congenital absence of the anus, i.e., the opening at the bottom end of the intestinal tract. Evidence: TAS. Frequency: Occasional (HP:0040283). (ORPHA:3242)
- High, narrow palate (HP:0002705): The presence of a high and narrow palate. Evidence: TAS. Frequency: Occasional (HP:0040283). (ORPHA:3242)
- Abnormal hairshaft morphology (HP:0003328): An abnormal structure of the hairshaft, i.e., of the nongrowing portion of a hair that protrudes from the skin. Evidence: TAS. Frequency: Occasional (HP:0040283). (ORPHA:3242)
- Clinodactyly of the 5th finger (HP:0004209): Clinodactyly refers to a bending or curvature of the fifth finger in the radial direction (i.e., towards the 4th finger). Evidence: TAS. Frequency: Occasional (HP:0040283). (ORPHA:3242)
- High hypermetropia (HP:0008499): A severe form of hypermetropia with over +5.00 diopters. Evidence: TAS. Frequency: Occasional (HP:0040283). (ORPHA:3242)
- Broad columella (HP:0010761): Increased width of the columella. Evidence: TAS. Frequency: Occasional (HP:0040283). (ORPHA:3242)
- Heterotaxy (HP:0030853): An abnormality in which the internal thoraco-abdominal organs demonstrate abnormal arrangement across the left-right axis of the body. Evidence: TAS. Frequency: Occasional (HP:0040283). (ORPHA:3242)